Phenotypes associated with the disease arrhythmogenic right ventricular dysplasia 12 (OMIM:611528):
- Woolly hair (HP:0002224): The term wooly hair refers to an abnormal variant of hair that is fine, with tightly coiled curls, and often hypopigmented. Optical microscopy may reveal the presence of tight spirals and a clear diameter reduction as compared with normal hair. Electron microscopy may show flat, oval hair shafts with reduced transversal diameter. Evidence: PCS. Frequency: 0/3. (PMID:17924338)
- Adult onset (HP:0003581): Onset of disease manifestations in adulthood, defined here as at the age of 16 years or later. Evidence: PCS. Frequency: 3/3. (PMID:17924338)
- T-wave inversion (HP:0010872): An inversion of the T-wave (which is normally positive). Evidence: PCS. Frequency: 1/1. (PMID:17924338)
- Right ventricular cardiomyopathy (HP:0011663): Right ventricular dysfunction (global or regional) with functional and morphological right ventricular abnormalities, with or without left ventricular disease. Evidence: PCS. Frequency: 3/3. (PMID:17924338)
- Ventricular arrhythmia (HP:0004308). Evidence: PCS. Frequency: 3/3. (PMID:17924338)
- Syncope (HP:0001279): A transient loss of consciousness (i.e., characterized by a rapid onset, a short duration, and a spontaneous and complete recovery) due to cerebral hypoperfusion. Evidence: PCS. (PMID:17924338)
- Palmoplantar keratoderma (HP:0000982): Abnormal thickening of the skin of the palms of the hands and the soles of the feet. Evidence: PCS. Frequency: 0/3. (PMID:17924338)
- Prolonged QRS complex (HP:0006677): Increased time for the complex comprised of the Q wave, R wave, and S wave as measured by the electrocardiogram (EKG).. In adults, normal values are 0.06 - 0.10 sec. Evidence: PCS. Frequency: 1/1. (PMID:17924338)
- Autosomal dominant inheritance (HP:0000006): A mode of inheritance that is observed for traits related to a gene encoded on one of the autosomes (i.e., the human chromosomes 1-22) in which a trait manifests in heterozygotes. In the context of medical genetics, an autosomal dominant disorder is caused when a single copy of the mutant allele is present. Males and females are affected equally, and can both transmit the disorder with a risk of 50% for each child of inheriting the mutant allele. Evidence: PCS. (PMID:17924338)
- Ventricular tachycardia (HP:0004756): A tachycardia originating in the ventricles characterized by rapid heart rate (over 100 beats per minute) and broad QRS complexes (over 120 ms). Evidence: PCS. (PMID:17924338)